Phenotypes associated with the disease Progressive deafness with stapes fixation (ORPHA:3235):
- Stapes ankylosis (HP:0000381): Stapes ankylosis refers to congenital or acquired fixation of the stapes (the stirrup-shaped small bone or ossicle in the middle ear), which is associated with conductive hearing resulting from impairment of the sound-conduction mechanism (the external auditory canal, tympanic membrane, and/or middle-ear ossicles). Evidence: TAS. Frequency: Very frequent (HP:0040281). (ORPHA:3235)
- Bilateral conductive hearing impairment (HP:0008513): A bilateral type of conductive hearing impairment. Evidence: TAS. Frequency: Very frequent (HP:0040281). (ORPHA:3235)